Phenotypes associated with the disease Mueller-Weiss syndrome (ORPHA:566943):
- Foot pain (HP:0025238): An unpleasant sensation characterized by physical discomfort (such as pricking, throbbing, or aching) localized to the foot. Evidence: TAS. Frequency: Very frequent (HP:0040281). (ORPHA:566943)
- Gait disturbance (HP:0001288): The term gait disturbance can refer to any disruption of the ability to walk. Evidence: TAS. Frequency: Frequent (HP:0040282). (ORPHA:566943)
- Joint stiffness (HP:0001387): Joint stiffness is a perceived sensation of tightness in a joint or joints when attempting to move them after a period of inactivity. Joint stiffness typically subsides over time. Evidence: TAS. Frequency: Frequent (HP:0040282). (ORPHA:566943)
- Positional foot deformity (HP:0005656): A foot deformity resulting due to an abnormality affecting the muscle and soft tissue. In contrast if the bones of the foot are affected the term structural foot deformity applies. Evidence: TAS. Frequency: Frequent (HP:0040282). (ORPHA:566943)
- Limitation of movement at ankles (HP:0010505): An abnormal limitation of the mobility of the ankle joint. Evidence: TAS. Frequency: Frequent (HP:0040282). (ORPHA:566943)
- Pedal edema (HP:0010741): An abnormal accumulation of excess fluid in the lower extremity resulting in swelling of the feet and extending upward to the lower leg. Evidence: TAS. Frequency: Frequent (HP:0040282). (ORPHA:566943)
- Avascular necrosis (HP:0010885): A disease where there is cellular death (necrosis) of bone components due to interruption of the blood supply. Evidence: TAS. Frequency: Frequent (HP:0040282). (ORPHA:566943)
- Edema of the dorsum of feet (HP:0012098): An abnormal accumulation of fluid beneath the skin on the back of the feet. Evidence: TAS. Frequency: Frequent (HP:0040282). (ORPHA:566943)
- Facet joint arthrosis (HP:0030871): Osteoarthritis of facet joints in the spine. Degeneration of cartilage in the facet joints results in bone rubbing on bone and reactive new bone formation visible on X-ray. Evidence: TAS. Frequency: Frequent (HP:0040282). (ORPHA:566943)
- Abnormality of the os naviculare pedis (HP:0100339). Evidence: TAS. Frequency: Frequent (HP:0040282). (ORPHA:566943)
- Chondritis (HP:0100662): Inflammation of cartilage. Evidence: TAS. Frequency: Frequent (HP:0040282). (ORPHA:566943)
- Sclerosis of foot bone (HP:0100925): An elevation in bone density in one or more foot bones. Sclerosis is normally detected on a radiograph as an area of increased opacity. Evidence: TAS. Frequency: Frequent (HP:0040282). (ORPHA:566943)
- Arthritis (HP:0001369): Inflammation of a joint. Evidence: TAS. Frequency: Occasional (HP:0040283). (ORPHA:566943)
- Pes planus (HP:0001763): A foot where the longitudinal arch of the foot is in contact with the ground or floor when the individual is standing; or, in a patient lying supine, a foot where the arch is in contact with the surface of a flat board pressed against the sole of the foot by the examiner with a pressure similar to that expected from weight bearing; or, the height of the arch is reduced. Evidence: TAS. Frequency: Occasional (HP:0040283). (ORPHA:566943)
- Fragmented, irregular epiphyses (HP:0005063). Evidence: TAS. Frequency: Occasional (HP:0040283). (ORPHA:566943)
- Knee osteoarthritis (HP:0005086). Evidence: TAS. Frequency: Occasional (HP:0040283). (ORPHA:566943)
- Equinovarus deformity (HP:0008110). Evidence: TAS. Frequency: Occasional (HP:0040283). (ORPHA:566943)
- Talipes calcaneovarus (HP:0008124): A congenital deformity characterized by a dorsiflexed, inverted, and adducted foot, i.e., a combination of talipes calcaneus and talipes varus. Evidence: TAS. Frequency: Occasional (HP:0040283). (ORPHA:566943)
- Joint subluxation (HP:0032153): A partial dislocation of a joint. Evidence: TAS. Frequency: Occasional (HP:0040283). (ORPHA:566943)
- Tibiofibular diastasis (HP:0100535). Evidence: TAS. Frequency: Occasional (HP:0040283). (ORPHA:566943)
- Tibial torsion (HP:0100694): Twisted position of the tibia (shin bone) associated with pathological rotation of the leg. Evidence: TAS. Frequency: Occasional (HP:0040283). (ORPHA:566943)